Phenotypes associated with the disease SUNCT syndrome (ORPHA:57145):
- Epiphora (HP:0009926): Abnormally increased lacrimation, that is, excessive tearing (watering eye). Evidence: TAS. Frequency: Very frequent (HP:0040281). (ORPHA:57145)
- Conjunctival hyperemia (HP:0030953): Dilatation of the blood vessels of the conjunctiva leading to a red appearance of the sclera. Evidence: TAS. Frequency: Very frequent (HP:0040281). (ORPHA:57145)
- Episodic pain (HP:0032148): Intermittent pain, i.e., pain that occurs occasionally and at irregular intervals. Evidence: TAS. Frequency: Very frequent (HP:0040281). (ORPHA:57145)
- Ptosis (HP:0000508): The upper eyelid margin is positioned 3 mm or more lower than usual and covers the superior portion of the iris (objective); or, the upper lid margin obscures at least part of the pupil (subjective). Evidence: TAS. Frequency: Frequent (HP:0040282). (ORPHA:57145)
- Restlessness (HP:0000711): A state of unease is characterized by diffuse motor activity or motion, which is subject to limited control, nonproductive, or disorganized behavior. Evidence: TAS. Frequency: Frequent (HP:0040282). (ORPHA:57145)
- Agitation (HP:0000713): A state of excessive motor activity that is associated with mental distress or a feeling of substantial unease or inner tension. Distinguished from restlessness by the increased level of emotional distress and negative intensity of the experience. Agitation has a significant level of physical activity that is typically threatening to the self or others. Evidence: TAS. Frequency: Frequent (HP:0040282). (ORPHA:57145)
- Hyperhidrosis (HP:0000975): Abnormal excessive perspiration (sweating) despite the lack of appropriate stimuli like hot and humid weather. Evidence: TAS. Frequency: Frequent (HP:0040282). (ORPHA:57145)
- Episodic hyperhidrosis (HP:0001069): Intermittent episodes of abnormally increased perspiration. Evidence: TAS. Frequency: Frequent (HP:0040282). (ORPHA:57145)
- Migraine (HP:0002076): Migraine is a chronic neurological disorder characterized by episodic attacks of headache and associated symptoms. Evidence: TAS. Frequency: Frequent (HP:0040282). (ORPHA:57145)
- Flushing (HP:0031284): Recurrent episodes of redness of the skin together with a sensation of warmth or burning of the affected areas of skin. Evidence: TAS. Frequency: Frequent (HP:0040282). (ORPHA:57145)
- Rhinorrhea (HP:0031417): Increased discharge of mucus from the nose. Evidence: TAS. Frequency: Frequent (HP:0040282). (ORPHA:57145)
- Increased tear production (HP:0031731): Increased lacrimation owing to overproduction of tears. Evidence: TAS. Frequency: Frequent (HP:0040282). (ORPHA:57145)
- Trigeminal neuralgia (HP:0100661): A neuropathic disorder characterized by episodes of intense pain in the face, originating from the trigeminal nerve. One, two, or all three branches of the nerve may be affected. Evidence: TAS. Frequency: Frequent (HP:0040282). (ORPHA:57145)
- Facial edema (HP:0000282). Evidence: TAS. Frequency: Occasional (HP:0040283). (ORPHA:57145)
- Photophobia (HP:0000613): Excessive sensitivity to light with the sensation of discomfort or pain in the eyes due to exposure to bright light. Evidence: TAS. Frequency: Occasional (HP:0040283). (ORPHA:57145)
- Miosis (HP:0000616): Abnormal (non-physiological) constriction of the pupil. Evidence: TAS. Frequency: Occasional (HP:0040283). (ORPHA:57145)
- Facial erythema (HP:0001041): Redness of the skin of the face, caused by hyperemia of the capillaries in the lower layers of the skin. Evidence: TAS. Frequency: Occasional (HP:0040283). (ORPHA:57145)
- Nasal congestion (HP:0001742): Reduced ability to pass air through the nasal cavity often leading to mouth breathing. Evidence: TAS. Frequency: Occasional (HP:0040283). (ORPHA:57145)
- Nausea (HP:0002018): A sensation of unease in the stomach together with an urge to vomit. Evidence: TAS. Frequency: Occasional (HP:0040283). (ORPHA:57145)
- Ear pain (HP:0030766): Pain in the ear can be a consequence of otologic disease (primary or otogenic otalgia), or can arise from pathologic processes and structures other than the ear (secondary or referred otalgia). Evidence: TAS. Frequency: Occasional (HP:0040283). (ORPHA:57145)
- Jaw pain (HP:0040264): An unpleasant sensation characterized by physical discomfort (such as pricking, throbbing, or aching) localized to the jaw. Evidence: TAS. Frequency: Occasional (HP:0040283). (ORPHA:57145)
- Palpebral edema (HP:0100540): Edema in the region of the eyelids. Evidence: TAS. Frequency: Occasional (HP:0040283). (ORPHA:57145)
- Vomiting (HP:0002013): Forceful ejection of the contents of the stomach through the mouth by means of a series of involuntary spasmic contractions. Evidence: TAS. Frequency: Very rare (HP:0040284). (ORPHA:57145)